- Ulcerative colitis (HP:0100279): A chronic inflammatory bowel disease that includes characteristic ulcers, or open sores, in the colon. The main symptom of active disease is usually constant diarrhea mixed with blood, of gradual onset and intermittent periods of exacerbated symptoms contrasting with periods that are relatively symptom-free. In contrast to Crohn's disease this special form of colitis begins in the distal parts of the rectum, spreads continually upwards and affects only mucose and submucose tissue of the colon. Evidence: TAS. (OMIM:612354)
- Autosomal dominant inheritance (HP:0000006): A mode of inheritance that is observed for traits related to a gene encoded on one of the autosomes (i.e., the human chromosomes 1-22) in which a trait manifests in heterozygotes. In the context of medical genetics, an autosomal dominant disorder is caused when a single copy of the mutant allele is present. Males and females are affected equally, and can both transmit the disorder with a risk of 50% for each child of inheriting the mutant allele. Evidence: TAS. (OMIM:612354)
These phenotypes are associated with the disease inflammatory bowel disease 21 (OMIM:612354).